Phenotypes associated with the disease microcephaly, cataracts, impaired intellectual development, and dystonia with abnormal striatum (OMIM:618284):
- Hypertonia (HP:0001276): A condition in which there is increased muscle tone so that arms or legs, for example, are stiff and difficult to move. Evidence: IEA. (OMIM:618284)
- Decreased body weight (HP:0004325): Abnormally low body weight. Evidence: PCS. Frequency: 4/4. (PMID:27582084)
- Microcephaly (HP:0000252): Head circumference below 2 standard deviations below the mean for age and gender. Evidence: PCS. Frequency: 4/4. (PMID:27582084)
- Congenital onset (HP:0003577): A phenotypic abnormality that is present at birth. Evidence: PCS. Frequency: 4/4. (PMID:27582084)
- Delayed speech and language development (HP:0000750): A degree of language development that is significantly below the norm for a child of a specified age. Evidence: PCS. Frequency: 3/4. (PMID:27582084)
- Short stature (HP:0004322): A height below that which is expected according to age and gender norms. Although there is no universally accepted definition of short stature, many refer to "short stature" as height more than 2 standard deviations below the mean for age and gender (or below the 3rd percentile for age and gender dependent norms). Evidence: PCS. Frequency: 4/4. (PMID:27582084)
- Babinski sign (HP:0003487): Upturning of the big toe (and sometimes fanning of the other toes) in response to stimulation of the sole of the foot. If the Babinski sign is present it can indicate damage to the corticospinal tract. Evidence: PCS. Frequency: 4/4. (PMID:27582084)
- Dystonia (HP:0001332): An abnormally increased muscular tone that causes fixed abnormal postures. There is a slow, intermittent twisting motion that leads to exaggerated turning and posture of the extremities and trunk. Evidence: PCS. Frequency: 4/4. (PMID:27582084)
- Dysarthria (HP:0001260): Dysarthric speech is a general description referring to a neurological speech disorder characterized by poor articulation. Depending on the involved neurological structures, dysarthria may be further classified as spastic, flaccid, ataxic, hyperkinetic and hypokinetic, or mixed. Evidence: PCS. Frequency: 4/4. (PMID:27582084)
- Cogwheel rigidity (HP:0002396): A type of rigidity in which a muscle responds with cogwheellike jerks to the use of constant force in bending the limb (i.e., it gives way in little, repeated jerks when the muscle is passively stretched). Evidence: PCS. Frequency: 4/4. (PMID:27582084)
- Spastic gait (HP:0002064): Spasticity is manifested by increased stretch reflex which is intensified with movement velocity. This results in excessive and inappropriate muscle activation which can contribute to muscle hypertonia. Spastic gait is characterized by manifestations such as muscle hypertonia, stiff knee, and circumduction of the leg. Evidence: PCS. Frequency: 4/4. (PMID:27582084)
- Delayed gross motor development (HP:0002194): A type of motor delay characterized by a delay in acquiring the ability to control the large muscles of the body for walking, running, sitting, and crawling. Evidence: PCS. Frequency: 4/4. (PMID:27582084)
- Developmental cataract (HP:0000519): A cataract that occurs congenitally as the result of a developmental defect, in contrast to the majority of cataracts that occur in adulthood as the result of degenerative changes of the lens. Evidence: PCS. Frequency: 4/4. Onset: Congenital onset (HP:0003577). (PMID:27582084)
- Autosomal recessive inheritance (HP:0000007): A mode of inheritance that is observed for traits related to a gene encoded on one of the autosomes (i.e., the human chromosomes 1-22) in which a trait manifests in individuals with two pathogenic alleles, either homozygotes (two copies of the same mutant allele) or compound heterozygotes (whereby each copy of a gene has a distinct mutant allele). Evidence: PCS. (PMID:27582084)
- Growth delay (HP:0001510): A deficiency or slowing down of growth pre- and postnatally. Evidence: PCS. Frequency: 4/4. (PMID:27582084)
- Attention deficit hyperactivity disorder (HP:0007018): Attention deficit hyperactivity disorder (ADHD) manifests at age 2-3 years or by first grade at the latest. The main symptoms are distractibility, impulsivity, hyperactivity, and often trouble organizing tasks and projects, difficulty going to sleep, and social problems from being aggressive, loud, or impatient. Evidence: PCS. Frequency: 4/4. (PMID:27582084)
- Intellectual disability (HP:0001249): The term intellectual disability or intellectual developmental disorder is used to describe significantly sub-average intellectual and adaptive functioning based on clinical assessment and as measured by individually administered, appropriately normed, standardized and validated tests of intellectual functioning and adaptive behavior, with onset during the developmental period from infancy through adolescence. Evidence: PCS. Frequency: 4/4. (PMID:27582084)
- Glaucoma (HP:0000501): Glaucoma refers loss of retinal ganglion cells in a characteristic pattern of optic neuropathy usually associated with increased intraocular pressure. Evidence: PCS. Frequency: 1/4. (PMID:27582084)